- Postaxial hand polydactyly (HP:0001162): Supernumerary digits located at the ulnar side of the hand (that is, on the side with the fifth finger). Evidence: IEA. (OMIM:258200)
- Autosomal recessive inheritance (HP:0000007): A mode of inheritance that is observed for traits related to a gene encoded on one of the autosomes (i.e., the human chromosomes 1-22) in which a trait manifests in individuals with two pathogenic alleles, either homozygotes (two copies of the same mutant allele) or compound heterozygotes (whereby each copy of a gene has a distinct mutant allele). Evidence: IEA. (OMIM:258200)
- Intellectual disability (HP:0001249): The term intellectual disability or intellectual developmental disorder is used to describe significantly sub-average intellectual and adaptive functioning based on clinical assessment and as measured by individually administered, appropriately normed, standardized and validated tests of intellectual functioning and adaptive behavior, with onset during the developmental period from infancy through adolescence. Evidence: IEA. (OMIM:258200)
These phenotypes are associated with the disease Oliver syndrome (OMIM:258200).